Phenotypes associated with the disease Cleft lip/palate-intestinal malrotation-cardiopathy syndrome (ORPHA:2001):
- Hypertelorism (HP:0000316): Interpupillary distance more than 2 SD above the mean (alternatively, the appearance of an increased interpupillary distance or widely spaced eyes). Evidence: TAS. Frequency: Very frequent (HP:0040281). (ORPHA:2001)
- Micrognathia (HP:0000347): Developmental hypoplasia of the mandible. Evidence: TAS. Frequency: Very frequent (HP:0040281). (ORPHA:2001)
- Short neck (HP:0000470): Diminished length of the neck. Evidence: TAS. Frequency: Very frequent (HP:0040281). (ORPHA:2001)
- Flat occiput (HP:0005469): Reduced convexity of the occiput (posterior part of skull). Evidence: TAS. Frequency: Very frequent (HP:0040281). (ORPHA:2001)
- Flat face (HP:0012368): Absence of concavity or convexity of the face when viewed in profile. Evidence: TAS. Frequency: Very frequent (HP:0040281). (ORPHA:2001)
- Abnormal cardiovascular system morphology (HP:0030680): Any structural anomaly of the heart and blood vessels. Evidence: TAS. Frequency: Very frequent (HP:0040281). (ORPHA:2001)
- Upslanted palpebral fissure (HP:0000582): The palpebral fissure inclination is more than two standard deviations above the mean for age (objective); or, the inclination of the palpebral fissure is greater than typical for age. Evidence: TAS. Frequency: Frequent (HP:0040282). (ORPHA:2001)
- Clinodactyly of the 5th finger (HP:0004209): Clinodactyly refers to a bending or curvature of the fifth finger in the radial direction (i.e., towards the 4th finger). Evidence: TAS. Frequency: Frequent (HP:0040282). (ORPHA:2001)
- Hypoplastic left ventricle (HP:0004383): A severe congenital heart defect characterized by underdevelopment of the left ventricle. Evidence: TAS. Frequency: Frequent (HP:0040282). (ORPHA:2001)
- Patent ductus arteriosus (HP:0001643): In utero, the ductus arteriosus (DA) serves to divert ventricular output away from the lungs and toward the placenta by connecting the main pulmonary artery to the descending aorta. A patent ductus arteriosus (PDA) in the first 3 days of life is a physiologic shunt in healthy term and preterm newborn infants, and normally is substantially closed within about 24 hours after bith and completely closed after about three weeks. Failure of physiologcal closure is referred to a persistent or patent ductus arteriosus (PDA). Depending on the degree of left-to-right shunting, PDA can have clinical consequences. Evidence: TAS. Frequency: Occasional (HP:0040283). (ORPHA:2001)
- Abnormal aortic morphology (HP:0001679): An abnormality of the aorta. Evidence: TAS. Frequency: Occasional (HP:0040283). (ORPHA:2001)
- Intestinal malrotation (HP:0002566): An abnormality of the intestinal rotation and fixation that normally occurs during the development of the gut. This can lead to volvulus, or twisting of the intestine that causes obstruction and necrosis. Evidence: TAS. Frequency: Occasional (HP:0040283). (ORPHA:2001)
- Bifid tongue (HP:0010297): Tongue with a median apical indentation or fork. Evidence: TAS. Frequency: Occasional (HP:0040283). (ORPHA:2001)
- Broad thumb (HP:0011304): Increased thumb width without increased dorso-ventral dimension. Evidence: TAS. Frequency: Occasional (HP:0040283). (ORPHA:2001)